- Global developmental delay (HP:0001263): A delay in the achievement of motor or mental milestones in the domains of development of a child, including motor skills, speech and language, cognitive skills, and social and emotional skills. This term should only be used to describe children younger than five years of age. Evidence: TAS. Frequency: Very frequent (HP:0040281). (ORPHA:254528)
- Polyhydramnios (HP:0001561): The presence of excess amniotic fluid in the uterus during pregnancy. Evidence: TAS. Frequency: Very frequent (HP:0040281). (ORPHA:254528)
- Thoracic hypoplasia (HP:0005257). Evidence: TAS. Frequency: Very frequent (HP:0040281). (ORPHA:254528)
- Coat hanger sign of ribs (HP:0006665): An abnormal morphology of the ribs consisting of shorted, abnormally curved ribs. On posteroanterior chest radiography, the ribs show a curvature resembling that of a coat hanger (clothes hanger). Evidence: TAS. Frequency: Very frequent (HP:0040281). (ORPHA:254528)
- Feeding difficulties (HP:0011968): Impaired ability to eat related to problems gathering food and getting ready to suck, chew, or swallow it. Evidence: TAS. Frequency: Very frequent (HP:0040281). (ORPHA:254528)
- Inguinal hernia (HP:0000023): Protrusion of the contents of the abdominal cavity through the inguinal canal. Evidence: TAS. Frequency: Frequent (HP:0040282). (ORPHA:254528)
- Flexion contracture (HP:0001371): A flexion contracture is a bent (flexed) joint that cannot be straightened actively or passively. It is thus a chronic loss of joint motion due to structural changes in muscle, tendons, ligaments, or skin that prevents normal movement of joints. Evidence: TAS. Frequency: Frequent (HP:0040282). (ORPHA:254528)
- Joint hypermobility (HP:0001382): The capability that a joint (or a group of joints) has to move, passively and/or actively, beyond normal limits along physiological axes. Evidence: TAS. Frequency: Frequent (HP:0040282). (ORPHA:254528)
- Umbilical hernia (HP:0001537): Protrusion of abdominal contents through a defect in the abdominal wall musculature around the umbilicus. Skin and subcutaneous tissue overlie the defect. Evidence: TAS. Frequency: Frequent (HP:0040282). (ORPHA:254528)
- Diastasis recti (HP:0001540): A separation of the rectus abdominis muscle into right and left halves (which are normally joined at the midline at the linea alba). Evidence: TAS. Frequency: Frequent (HP:0040282). (ORPHA:254528)
- Respiratory failure (HP:0002878): A severe form of respiratory insufficiency characterized by inadequate gas exchange such that the levels of oxygen or carbon dioxide cannot be maintained within normal limits. Evidence: TAS. Frequency: Frequent (HP:0040282). (ORPHA:254528)
- Large placenta (HP:0006267): Increased size of the placenta. Evidence: TAS. Frequency: Frequent (HP:0040282). (ORPHA:254528)
- Postnatal growth retardation (HP:0008897): Slow or limited growth after birth. Evidence: TAS. Frequency: Frequent (HP:0040282). (ORPHA:254528)
- Hydronephrosis (HP:0000126): Severe distention of the kidney with dilation of the renal pelvis and calices. Evidence: TAS. Frequency: Occasional (HP:0040283). (ORPHA:254528)
- Macroglossia (HP:0000158): Increased length and width of the tongue. Evidence: TAS. Frequency: Occasional (HP:0040283). (ORPHA:254528)
- Open mouth (HP:0000194): A facial appearance characterized by a permanently or nearly permanently opened mouth. Evidence: TAS. Frequency: Occasional (HP:0040283). (ORPHA:254528)
- Retrognathia (HP:0000278): An abnormality in which the mandible is mislocalised posteriorly. Evidence: TAS. Frequency: Occasional (HP:0040283). (ORPHA:254528)
- Epicanthus (HP:0000286): A fold of skin starting above the medial aspect of the upper eyelid and arching downward to cover, pass in front of and lateral to the medial canthus. Evidence: TAS. Frequency: Occasional (HP:0040283). (ORPHA:254528)
- Broad forehead (HP:0000337): Width of the forehead or distance between the frontotemporales is more than two standard deviations above the mean (objective); or apparently increased distance between the two sides of the forehead. Evidence: TAS. Frequency: Occasional (HP:0040283). (ORPHA:254528)
- Narrow forehead (HP:0000341): Width of the forehead or distance between the frontotemporales is more than two standard deviations below the mean (objective); or apparently narrow intertemporal region (subjective). Evidence: TAS. Frequency: Occasional (HP:0040283). (ORPHA:254528)
- Anteverted nares (HP:0000463): Anteriorly-facing nostrils viewed with the head in the Frankfurt horizontal and the eyes of the observer level with the eyes of the subject. This gives the appearance of an upturned nose (upturned nasal tip). Evidence: TAS. Frequency: Occasional (HP:0040283). (ORPHA:254528)
- Esotropia (HP:0000565): A form of strabismus with one or both eyes turned inward ('crossed') to a relatively severe degree, usually defined as 10 diopters or more. Evidence: TAS. Frequency: Occasional (HP:0040283). (ORPHA:254528)
- Pectus excavatum (HP:0000767): A defect of the chest wall characterized by a depression of the sternum, giving the chest ("pectus") a caved-in ("excavatum") appearance. Evidence: TAS. Frequency: Occasional (HP:0040283). (ORPHA:254528)
- Prominent sternum (HP:0000884). Evidence: TAS. Frequency: Occasional (HP:0040283). (ORPHA:254528)
- Single transverse palmar crease (HP:0000954): The distal and proximal transverse palmar creases are merged into a single transverse palmar crease. Evidence: TAS. Frequency: Occasional (HP:0040283). (ORPHA:254528)
- Wrist flexion contracture (HP:0001239): A chronic loss of wrist joint motion due to structural changes in muscle, tendons, ligaments, or skin that prevent normal movement of the joints of the wrist. Evidence: TAS. Frequency: Occasional (HP:0040283). (ORPHA:254528)
- Hypotonia (HP:0001252): Hypotonia is an abnormally low muscle tone (the amount of tension or resistance to movement in a muscle). Even when relaxed, muscles have a continuous and passive partial contraction which provides some resistance to passive stretching. Hypotonia thus manifests as diminished resistance to passive stretching. Hypotonia is not the same as muscle weakness, although the two conditions can co-exist. Evidence: TAS. Frequency: Occasional (HP:0040283). (ORPHA:254528)
- Omphalocele (HP:0001539): A midline anterior incomplete closure of the abdominal wall in which there is herniation of the abdominal viscera into the base of the abdominal cord. Evidence: TAS. Frequency: Occasional (HP:0040283). (ORPHA:254528)
- Laryngomalacia (HP:0001601): Laryngomalacia is a congenital abnormality of the laryngeal cartilage in which the cartilage is floppy and prolapses over the larynx during inspiration. Evidence: TAS. Frequency: Occasional (HP:0040283). (ORPHA:254528)
- Overlapping toe (HP:0001845): Describes a foot digit resting on the dorsal surface of an adjacent digit when the foot is at rest. Initially clawing may be dynamic and only noticeable on walking. Over time the plantar plate tears, subluxation occurs at the metatarsophalangeal joint (MTPJ), and the deformity becomes permanent. Evidence: TAS. Frequency: Occasional (HP:0040283). (ORPHA:254528)
- Exaggerated cupid's bow (HP:0002263): More pronounced paramedian peaks and median notch of the Cupid's bow. Evidence: TAS. Frequency: Occasional (HP:0040283). (ORPHA:254528)
- Depressed nasal bridge (HP:0005280): Posterior positioning of the nasal root in relation to the overall facial profile for age. Evidence: TAS. Frequency: Occasional (HP:0040283). (ORPHA:254528)
- Redundant neck skin (HP:0005989): Excess skin around the neck, often lying in horizontal folds. Evidence: TAS. Frequency: Occasional (HP:0040283). (ORPHA:254528)
- Long toe (HP:0010511): Toes that appear disproportionately long compared to the foot. Evidence: TAS. Frequency: Occasional (HP:0040283). (ORPHA:254528)
- Camptodactyly (HP:0012385): The distal interphalangeal joint and/or the proximal interphalangeal joint of the fingers or toes cannot be extended to 180 degrees by either active or passive extension. Evidence: TAS. Frequency: Occasional (HP:0040283). (ORPHA:254528)
- Flexion contracture of finger (HP:0012785): Chronic loss of joint motion in a finger due to structural changes in non-bony tissue. Evidence: TAS. Frequency: Occasional (HP:0040283). (ORPHA:254528)
- Narrow palpebral fissure (HP:0045025): Reduction in the vertical distance between the upper and lower eyelids. Evidence: TAS. Frequency: Occasional (HP:0040283). (ORPHA:254528)
- Intrauterine growth retardation (HP:0001511): An abnormal restriction of fetal growth with fetal weight below the tenth percentile for gestational age. Evidence: TAS. Frequency: Very rare (HP:0040284). (ORPHA:254528)
These phenotypes are associated with the disease Kagami-Ogata syndrome due to maternal 14q32.2 microdeletion (ORPHA:254528).